- Postaxial hand polydactyly (HP:0001162): Supernumerary digits located at the ulnar side of the hand (that is, on the side with the fifth finger). Evidence: TAS. Frequency: Very frequent (HP:0040281). (ORPHA:1892)
- Ectrodactyly (HP:0100257): A condition in which middle parts of the hands and/or feet (digits and meta-carpals and -tarsals) are missing giving a cleft appearance. The severity is very variable ranging from slightly hypoplastic 3rd toe/fingers over absent 2nd or 3rd toes/fingers as far as oligo- or monodactyl hands and/or feet. Evidence: TAS. Frequency: Very frequent (HP:0040281). (ORPHA:1892)
- Brachydactyly (HP:0001156): Digits that appear disproportionately short compared to the hand/foot. The word brachydactyly is used here to describe a series distinct patterns of shortened digits (brachydactyly types A-E). This is the sense used here. Evidence: TAS. Frequency: Frequent (HP:0040282). (ORPHA:1892)
- Abnormal metacarpal morphology (HP:0005916): Any abnormal shape or structure of the metacarpal bones. Evidence: TAS. Frequency: Frequent (HP:0040282). (ORPHA:1892)
- Finger syndactyly (HP:0006101): Webbing or fusion of the fingers, involving soft parts only or including bone structure. Bony fusions are referred to as "bony" Syndactyly if the fusion occurs in a radio-ulnar axis. Fusions of bones of the fingers in a proximo-distal axis are referred to as "Symphalangism". Evidence: TAS. Frequency: Frequent (HP:0040282). (ORPHA:1892)
- Finger symphalangism (HP:0009700): An abnormal union between bones or parts of bones of the fingers. The synonymous term "symphalangism of the hand" may be translated as fusions of bones of varying digree, that involve at least one phalangeal bone of the hand. If bony fusions are referred to as "Symphalangism" the fusion occurs in a proximo-distal axis. Fusions of bones of the fingers in a radio-ulnar axis are referred to as "bony" Syndactyly. Evidence: TAS. Frequency: Frequent (HP:0040282). (ORPHA:1892)
- Camptodactyly of finger (HP:0100490): The distal interphalangeal joint and/or the proximal interphalangeal joint of the fingers cannot be extended to 180 degrees by either active or passive extension. Evidence: TAS. Frequency: Frequent (HP:0040282). (ORPHA:1892)
These phenotypes are associated with the disease Ectrodactyly-polydactyly syndrome (ORPHA:1892).